Phenotypes associated with the disease mesoaxial hexadactyly and cardiac malformation (OMIM:249670):
- Torticollis (HP:0000473): Involuntary contractions of the neck musculature resulting in an abnormal posture of or abnormal movements of the head. Evidence: IEA. (OMIM:249670)
- Mild intellectual disability (HP:0001256): Mild intellectual disability (ID) is defined as a type of ID characterized by mildly sub-average adaptive functioning and intellectual functioning, with an intelligence quotient (IQ) the range of 50-69. Evidence: IEA. (OMIM:249670)
- Everted lower lip vermilion (HP:0000232): An abnormal configuration of the lower lip such that it is turned outward i.e., everted, with the Inner aspect of the lower lip vermilion (normally opposing the teeth) being visible in a frontal view. Evidence: IEA. (OMIM:249670)
- Short stature (HP:0004322): A height below that which is expected according to age and gender norms. Although there is no universally accepted definition of short stature, many refer to "short stature" as height more than 2 standard deviations below the mean for age and gender (or below the 3rd percentile for age and gender dependent norms). Evidence: IEA. (OMIM:249670)
- Ventricular septal defect (HP:0001629): A hole between the two bottom chambers (ventricles) of the heart. The defect is centered around the most superior aspect of the ventricular septum. Evidence: IEA. (OMIM:249670)
- Hand polydactyly (HP:0001161): A kind of polydactyly characterized by the presence of a supernumerary finger or fingers. Evidence: IEA. (OMIM:249670)
- External genital hypoplasia (HP:0003241): Underdevelopment of part or all of the external reproductive organs. Evidence: IEA. (OMIM:249670)
- Autosomal recessive inheritance (HP:0000007): A mode of inheritance that is observed for traits related to a gene encoded on one of the autosomes (i.e., the human chromosomes 1-22) in which a trait manifests in individuals with two pathogenic alleles, either homozygotes (two copies of the same mutant allele) or compound heterozygotes (whereby each copy of a gene has a distinct mutant allele). Evidence: IEA. (OMIM:249670)
- Abnormal 3rd finger morphology (HP:0004150): An anomaly of the third finger. Evidence: IEA. (OMIM:249670)
- Patent ductus arteriosus (HP:0001643): In utero, the ductus arteriosus (DA) serves to divert ventricular output away from the lungs and toward the placenta by connecting the main pulmonary artery to the descending aorta. A patent ductus arteriosus (PDA) in the first 3 days of life is a physiologic shunt in healthy term and preterm newborn infants, and normally is substantially closed within about 24 hours after bith and completely closed after about three weeks. Failure of physiologcal closure is referred to a persistent or patent ductus arteriosus (PDA). Depending on the degree of left-to-right shunting, PDA can have clinical consequences. Evidence: IEA. (OMIM:249670)
- Atrial septal defect (HP:0001631): Atrial septal defect (ASD) is a congenital abnormality of the interatrial septum that enables blood flow between the left and right atria via the interatrial septum. Evidence: IEA. (OMIM:249670)
- Pulmonic stenosis (HP:0001642): A narrowing of the right ventricular outflow tract that can occur at the pulmonary valve (valvular stenosis), below the pulmonary valve (infundibular stenosis), or above the pulmonary valve (supravalvar stenosis). Evidence: TAS. (OMIM:249670)